Phenotypes associated with the disease platelet-type bleeding disorder 9 (OMIM:614200):
- Congenital onset (HP:0003577): A phenotypic abnormality that is present at birth. Evidence: TAS. (OMIM:614200)
- Bruising susceptibility (HP:0000978): An ecchymosis (bruise) refers to the skin discoloration caused by the escape of blood into the tissues from ruptured blood vessels. This term refers to an abnormally increased susceptibility to bruising. The corresponding phenotypic abnormality is generally elicited on medical history as a report of frequent ecchymoses or bruising without adequate trauma. Evidence: TAS. (OMIM:614200)
- Thrombocytopenia (HP:0001873): A reduction in the number of circulating thrombocytes. Evidence: TAS. (OMIM:614200)
- Autosomal dominant inheritance (HP:0000006): A mode of inheritance that is observed for traits related to a gene encoded on one of the autosomes (i.e., the human chromosomes 1-22) in which a trait manifests in heterozygotes. In the context of medical genetics, an autosomal dominant disorder is caused when a single copy of the mutant allele is present. Males and females are affected equally, and can both transmit the disorder with a risk of 50% for each child of inheriting the mutant allele. Evidence: TAS. (OMIM:614200)